- Abnormal morphology of female internal genitalia (HP:0000008): An abnormality of the female internal genitalia. Evidence: TAS. Frequency: Occasional (HP:0040283). (ORPHA:1790)
- Narrow mouth (HP:0000160): Distance between the commissures of the mouth more than 2 SD below the mean. Alternatively, an apparently decreased width of the oral aperture (subjective). Evidence: TAS. Frequency: Frequent (HP:0040282). (ORPHA:1790)
- Cleft palate (HP:0000175): Cleft palate is a developmental defect of the palate resulting from a failure of fusion of the palatine processes and manifesting as a separation of the roof of the mouth (soft and hard palate). Evidence: TAS. Frequency: Frequent (HP:0040282). (ORPHA:1790)
- Bifid uvula (HP:0000193): Uvula separated into two parts most easily seen at the tip. Evidence: TAS. Frequency: Frequent (HP:0040282). (ORPHA:1790)
- Trigonocephaly (HP:0000243): Wedge-shaped, or triangular head, with the apex of the triangle at the midline of the forehead and the base of the triangle at the occiput. Evidence: TAS. Frequency: Occasional (HP:0040283). (ORPHA:1790)
- Brachycephaly (HP:0000248): An abnormality of skull shape characterized by a decreased anterior-posterior diameter. That is, a cephalic index greater than 81%. Alternatively, an apparently shortened anteroposterior dimension (length) of the head compared to width. Evidence: TAS. Frequency: Frequent (HP:0040282). (ORPHA:1790)
- Low-set ears (HP:0000369): Upper insertion of the ear to the scalp below an imaginary horizontal line drawn between the inner canthi of the eye and extending posteriorly to the ear. Evidence: TAS. Frequency: Very frequent (HP:0040281). (ORPHA:1790)
- Choanal stenosis (HP:0000452): Abnormal narrowing of the choana (the posterior nasal aperture). Evidence: TAS. Frequency: Frequent (HP:0040282). (ORPHA:1790)
- Anteverted nares (HP:0000463): Anteriorly-facing nostrils viewed with the head in the Frankfurt horizontal and the eyes of the observer level with the eyes of the subject. This gives the appearance of an upturned nose (upturned nasal tip). Evidence: TAS. Frequency: Very frequent (HP:0040281). (ORPHA:1790)
- Downslanted palpebral fissures (HP:0000494): The palpebral fissure inclination is more than two standard deviations below the mean. Evidence: TAS. Frequency: Frequent (HP:0040282). (ORPHA:1790)
- Proptosis (HP:0000520): An eye that is protruding anterior to the plane of the face to a greater extent than is typical. Evidence: TAS. Frequency: Frequent (HP:0040282). (ORPHA:1790)
- Upslanted palpebral fissure (HP:0000582): The palpebral fissure inclination is more than two standard deviations above the mean for age (objective); or, the inclination of the palpebral fissure is greater than typical for age. Evidence: TAS. Frequency: Occasional (HP:0040283). (ORPHA:1790)
- Optic disc coloboma (HP:0000588): A cleft of the optic nerve that extends inferiorly. Evidence: TAS. Frequency: Frequent (HP:0040282). (ORPHA:1790)
- Craniosynostosis (HP:0001363): Craniosynostosis refers to the premature closure of the cranial sutures. Primary craniosynostosis refers to the closure of one or more sutures due to abnormalities in skull development, and secondary craniosynostosis results from failure of brain growth. Evidence: TAS. Frequency: Frequent (HP:0040282). (ORPHA:1790)
- Death in infancy (HP:0001522): Death within the first 24 months of life. Evidence: TAS. Frequency: Occasional (HP:0040283). (ORPHA:1790)
- Polyhydramnios (HP:0001561): The presence of excess amniotic fluid in the uterus during pregnancy. Evidence: TAS. Frequency: Frequent (HP:0040282). (ORPHA:1790)
- Atrial septal defect (HP:0001631): Atrial septal defect (ASD) is a congenital abnormality of the interatrial septum that enables blood flow between the left and right atria via the interatrial septum. Evidence: TAS. Frequency: Occasional (HP:0040283). (ORPHA:1790)
- Patent ductus arteriosus (HP:0001643): In utero, the ductus arteriosus (DA) serves to divert ventricular output away from the lungs and toward the placenta by connecting the main pulmonary artery to the descending aorta. A patent ductus arteriosus (PDA) in the first 3 days of life is a physiologic shunt in healthy term and preterm newborn infants, and normally is substantially closed within about 24 hours after bith and completely closed after about three weeks. Failure of physiologcal closure is referred to a persistent or patent ductus arteriosus (PDA). Depending on the degree of left-to-right shunting, PDA can have clinical consequences. Evidence: TAS. Frequency: Occasional (HP:0040283). (ORPHA:1790)
- Recurrent respiratory infections (HP:0002205): An increased susceptibility to respiratory infections as manifested by a history of recurrent respiratory infections. Evidence: TAS. Frequency: Very frequent (HP:0040281). (ORPHA:1790)
- Tracheal stenosis (HP:0002777). Evidence: TAS. Frequency: Occasional (HP:0040283). (ORPHA:1790)
- Short nose (HP:0003196): Distance from nasion to subnasale more than two standard deviations below the mean, or alternatively, an apparently decreased length from the nasal root to the nasal tip. Evidence: TAS. Frequency: Very frequent (HP:0040281). (ORPHA:1790)
- Maxillozygomatic hypoplasia (HP:0005439): Hypoplasia of the maxillozygomatic complex. Evidence: TAS. Frequency: Very frequent (HP:0040281). (ORPHA:1790)
- Abnormal tracheobronchial morphology (HP:0005607). Evidence: TAS. Frequency: Very frequent (HP:0040281). (ORPHA:1790)
- Laryngeal hypoplasia (HP:0008749): Underdevelopment of the larynx. Evidence: TAS. Frequency: Frequent (HP:0040282). (ORPHA:1790)
- Aplasia/Hypoplasia of the tongue (HP:0010295): Absence or underdevelopment of the tongue. Evidence: TAS. Frequency: Very frequent (HP:0040281). (ORPHA:1790)
- Midface retrusion (HP:0011800): Posterior positions and/or vertical shortening of the infraorbital and perialar regions, or increased concavity of the face and/or reduced nasolabial angle. Evidence: TAS. Frequency: Very frequent (HP:0040281). (ORPHA:1790)
- Cognitive impairment (HP:0100543): Abnormal cognition is characterized by deficits in thinking, reasoning, or remembering. Evidence: TAS. Frequency: Very frequent (HP:0040281). (ORPHA:1790)
These phenotypes are associated with the disease Hypomandibular faciocranial dysostosis (ORPHA:1790).